- Miscarriage (HP:0005268): A pregnancy that ends at a stage in which the fetus is incapable of surviving on its own, defined as the spontaneous loss of a fetus before the 22th week of pregnancy. Evidence: IEA. (OMIM:136580)
- Abnormality of chromosome segregation (HP:0002916): An abnormality of chromosome segregation. Evidence: IEA. (OMIM:136580)
- Infertility (HP:0000789). Evidence: IEA. (OMIM:136580)
- Abnormal lymph node morphology (HP:0002733): A structural lymph node abnormality. Evidence: IEA. (OMIM:136580)
These phenotypes are associated with the disease Fragile site 16q22 (OMIM:136580).